Phenotypes associated with the disease autosomal dominant nonsyndromic hearing loss 5 (OMIM:600994):
- Progressive sensorineural hearing impairment (HP:0000408): A progressive form of sensorineural hearing impairment. Evidence: TAS. (OMIM:600994)
- Autosomal dominant inheritance (HP:0000006): A mode of inheritance that is observed for traits related to a gene encoded on one of the autosomes (i.e., the human chromosomes 1-22) in which a trait manifests in heterozygotes. In the context of medical genetics, an autosomal dominant disorder is caused when a single copy of the mutant allele is present. Males and females are affected equally, and can both transmit the disorder with a risk of 50% for each child of inheriting the mutant allele. Evidence: TAS. (OMIM:600994)